- Abnormal retinal morphology (HP:0000479): A structural abnormality of the retina. Evidence: TAS. Frequency: Frequent (HP:0040282). (ORPHA:88629)
- Tritanomaly (HP:0000552): Difficulty distinguishing between yellow and blue, possible related to dysfunction of the S photopigment. Evidence: TAS. Frequency: Frequent (HP:0040282). (ORPHA:88629)
- Color vision test abnormality (HP:0030584). Evidence: TAS. Frequency: Frequent (HP:0040282). (ORPHA:88629)
- Photophobia (HP:0000613): Excessive sensitivity to light with the sensation of discomfort or pain in the eyes due to exposure to bright light. Evidence: TAS. Frequency: Occasional (HP:0040283). (ORPHA:88629)
- Reduced visual acuity (HP:0007663). Evidence: TAS. Frequency: Occasional (HP:0040283). (ORPHA:88629)
- Pendular nystagmus (HP:0012043): Rhythmic, involuntary sinusoidal oscillations of one or both eyes. The waveform of pendular nystagmus may occur in any direction. Evidence: TAS. Frequency: Occasional (HP:0040283). (ORPHA:88629)
These phenotypes are associated with the disease Tritanopia (ORPHA:88629).